- Sensorineural hearing impairment (HP:0000407): A type of hearing impairment in one or both ears related to an abnormal functionality of the cochlear nerve. Evidence: PCS. (PMID:12107438)
- Autosomal recessive inheritance (HP:0000007): A mode of inheritance that is observed for traits related to a gene encoded on one of the autosomes (i.e., the human chromosomes 1-22) in which a trait manifests in individuals with two pathogenic alleles, either homozygotes (two copies of the same mutant allele) or compound heterozygotes (whereby each copy of a gene has a distinct mutant allele). Evidence: PCS. (PMID:12107438)
These phenotypes are associated with the disease autosomal recessive nonsyndromic hearing loss 18A (OMIM:602092).